- Severe short stature (HP:0003510): A severe degree of short stature, more than -4 SD from the mean corrected for age and sex. Evidence: PCS. Frequency: 1/1. (PMID:13679528)
- Lymphocytic interstitial pneumonia (HP:0006527): Lymphocytic interstitial pneumonitis is a benign lymphoproliferative disorder of the lung that is characterized by the presence of a dense, predominantly lymphocytic interstitial infiltrate (lymphocytes, plasma cells, other elements of the lymphoreticular system) that expands the alveolar septa. Evidence: PCS. Frequency: 1/1. Onset: Childhood onset (HP:0011463). (PMID:13679528)
- Respiratory distress (HP:0002098): Respiratory distress is objectively observable as the physical or emotional consequences from the experience of dyspnea. The physical presentation of respiratory distress is generally referred to as labored breathing, while the sensation of respiratory distress is called shortness of breath or dyspnea. Evidence: IEA. Frequency: 1/1. (PMID:13679528)
- Failure to thrive (HP:0001508): Failure to thrive (FTT) refers to a child whose physical growth is substantially below the norm. Evidence: PCS. Frequency: 1/1. Onset: Infantile onset (HP:0003593). (PMID:13679528)
- Prominent forehead (HP:0011220): Forward prominence of the entire forehead, due to protrusion of the frontal bone. Evidence: PCS. Frequency: 1/1. (PMID:13679528)
- Concave nasal ridge (HP:0011120): Nasal ridge curving posteriorly to an imaginary line that connects the nasal root and tip. Evidence: PCS. Frequency: 1/1. (PMID:13679528)
- Autosomal recessive inheritance (HP:0000007): A mode of inheritance that is observed for traits related to a gene encoded on one of the autosomes (i.e., the human chromosomes 1-22) in which a trait manifests in individuals with two pathogenic alleles, either homozygotes (two copies of the same mutant allele) or compound heterozygotes (whereby each copy of a gene has a distinct mutant allele). Evidence: PCS. (PMID:13679528)
- Decreased response to growth hormone stimulation test (HP:0000824): Insufficient responses to growth hormone (GH) provocation tests. GH deficiency is defined as a serum peak GH concentration less than 10 ng/mL on provocation with a combination of at least two separate stimulation tests. Evidence: PCS. Frequency: 1/1. (PMID:13679528)
- Abnormally high-pitched voice (HP:0001620): A persistent (minutes to hours) abnormal increase in the pitch (frequency) of the voice for the context or social situation or significantly different from baseline of the individual. Evidence: PCS. Frequency: 1/1. (PMID:13679528)
These phenotypes are associated with the disease growth hormone insensitivity with immune dysregulation 1, autosomal recessive (OMIM:245590).